Phenotypes associated with the disease febrile seizures, familial, 5 (OMIM:609255):
- Bilateral tonic-clonic seizure (HP:0002069): A bilateral tonic-clonic seizure is a seizure defined by a tonic (bilateral increased tone, lasting seconds to minutes) and then a clonic (bilateral sustained rhythmic jerking) phase. Evidence: TAS. (OMIM:609255)
- Febrile seizure (within the age range of 3 months to 6 years) (HP:0002373): A febrile seizure is any type of seizure (most often a generalized tonic-clonic seizure) occurring with fever (at least 38 degrees Celsius) but in the absence of central nervous system infection, severe metabolic disturbance or other alternative precipitant in children between the ages of 3 months and 6 years. Evidence: PCS. (PMID:12429594)
- Childhood onset (HP:0011463): Onset of disease at the age of between 1 and 5 years. Evidence: PCS. Frequency: 20/20. (PMID:12429594;OMIM:609255)
- Atonic seizure (HP:0010819): Atonic seizure is a type of motor seizure characterized by a sudden loss or diminution of muscle tone without apparent preceding myoclonic or tonic event lasting about 1 to 2 seconds, involving head, trunk, jaw, or limb musculature. Evidence: TAS. (OMIM:609255)
- Generalized tonic seizure (HP:0010818): A generalized tonic seizure is a type of generalized motor seizure characterized by bilateral limb stiffening or elevation, often with neck stiffening without a subsequent clonic phase. The tonic activity can be a sustained abnormal posture, either in extension or flexion, sometimes accompanied by tremor of the extremities. Evidence: TAS. (OMIM:609255)
- Infantile onset (HP:0003593): Onset of signs or symptoms of disease between 28 days to one year of life. Evidence: PCS. (PMID:12429594)
- Autosomal dominant inheritance (HP:0000006): A mode of inheritance that is observed for traits related to a gene encoded on one of the autosomes (i.e., the human chromosomes 1-22) in which a trait manifests in heterozygotes. In the context of medical genetics, an autosomal dominant disorder is caused when a single copy of the mutant allele is present. Males and females are affected equally, and can both transmit the disorder with a risk of 50% for each child of inheriting the mutant allele. Evidence: PCS. (PMID:12429594)